Phenotypes associated with the disease Carney-Stratakis syndrome (OMIM:606864):
- Neoplasm of the gastrointestinal tract (HP:0007378): A tumor (abnormal growth of tissue) of the gastrointestinal tract. Evidence: TAS. (OMIM:606864)
- Paraganglioma (HP:0002668): A carotid body tumor (also called paraganglionoma or chemodectoma) is a tumor found in the upper neck at the branching of the carotid artery. They arise from the chemoreceptor organ (paraganglion) located in the adventitia of the carotid artery bifurcation. Evidence: TAS. (OMIM:606864)